- Hydronephrosis (HP:0000126): Severe distention of the kidney with dilation of the renal pelvis and calices. Evidence: TAS. Frequency: Occasional (HP:0040283). (ORPHA:1358)
- Glossoptosis (HP:0000162): Posterior displacement of the tongue into the pharynx, i.e., a tongue that is mislocalised posteriorly. Evidence: TAS. Frequency: Frequent (HP:0040282). (ORPHA:1358)
- Cleft palate (HP:0000175): Cleft palate is a developmental defect of the palate resulting from a failure of fusion of the palatine processes and manifesting as a separation of the roof of the mouth (soft and hard palate). Evidence: TAS. Frequency: Frequent (HP:0040282). (ORPHA:1358)
- Pierre-Robin sequence (HP:0000201): Pierre Robin malformation is a sequence of developmental malformations characterized by micrognathia (mandibular hypoplasia), glossoptosis and cleft palate. Evidence: TAS. Frequency: Very frequent (HP:0040281). (ORPHA:1358)
- High palate (HP:0000218): Height of the palate more than 2 SD above the mean (objective) or palatal height at the level of the first permanent molar more than twice the height of the teeth (subjective). Evidence: TAS. Frequency: Frequent (HP:0040282). (ORPHA:1358)
- Thin vermilion border (HP:0000233): Height of the vermilion of the medial part of the lip more than 2 SD below the mean, or apparently reduced height of the vermilion of the lip in the frontal view. The vermilion is the red part of the lips (and confusingly, the vermilion itself is also often referred to as being equivalent the lips). Evidence: TAS. Frequency: Very frequent (HP:0040281). (ORPHA:1358)
- Microcephaly (HP:0000252): Head circumference below 2 standard deviations below the mean for age and gender. Evidence: TAS. Frequency: Frequent (HP:0040282). (ORPHA:1358)
- Epicanthus (HP:0000286): A fold of skin starting above the medial aspect of the upper eyelid and arching downward to cover, pass in front of and lateral to the medial canthus. Evidence: TAS. Frequency: Very frequent (HP:0040281). (ORPHA:1358)
- Long philtrum (HP:0000343): Distance between nasal base and midline upper lip vermilion border more than 2 SD above the mean. Alternatively, an apparently increased distance between nasal base and midline upper lip vermilion border. Evidence: TAS. Frequency: Very frequent (HP:0040281). (ORPHA:1358)
- Micrognathia (HP:0000347): Developmental hypoplasia of the mandible. Evidence: TAS. Frequency: Very frequent (HP:0040281). (ORPHA:1358)
- Anteverted nares (HP:0000463): Anteriorly-facing nostrils viewed with the head in the Frankfurt horizontal and the eyes of the observer level with the eyes of the subject. This gives the appearance of an upturned nose (upturned nasal tip). Evidence: TAS. Frequency: Very frequent (HP:0040281). (ORPHA:1358)
- Downslanted palpebral fissures (HP:0000494): The palpebral fissure inclination is more than two standard deviations below the mean. Evidence: TAS. Frequency: Very frequent (HP:0040281). (ORPHA:1358)
- Ptosis (HP:0000508): The upper eyelid margin is positioned 3 mm or more lower than usual and covers the superior portion of the iris (objective); or, the upper lid margin obscures at least part of the pupil (subjective). Evidence: TAS. Frequency: Very frequent (HP:0040281). (ORPHA:1358)
- Impaired ocular abduction (HP:0000634): An impaired ability of the eye to move in the outward direction (towards the side of the head). Evidence: TAS. Frequency: Very frequent (HP:0040281). (ORPHA:1358)
- Glanular hypospadias (HP:0000807): A type of hypospadias in which the urethral meatus is located at the head of the penis, but not all the way at the tip. Evidence: TAS. Frequency: Occasional (HP:0040283). (ORPHA:1358)
- Brachydactyly (HP:0001156): Digits that appear disproportionately short compared to the hand/foot. The word brachydactyly is used here to describe a series distinct patterns of shortened digits (brachydactyly types A-E). This is the sense used here. Evidence: TAS. Frequency: Very frequent (HP:0040281). (ORPHA:1358)
- Intellectual disability (HP:0001249): The term intellectual disability or intellectual developmental disorder is used to describe significantly sub-average intellectual and adaptive functioning based on clinical assessment and as measured by individually administered, appropriately normed, standardized and validated tests of intellectual functioning and adaptive behavior, with onset during the developmental period from infancy through adolescence. Evidence: TAS. Frequency: Frequent (HP:0040282). (ORPHA:1358)
- Hypotonia (HP:0001252): Hypotonia is an abnormally low muscle tone (the amount of tension or resistance to movement in a muscle). Even when relaxed, muscles have a continuous and passive partial contraction which provides some resistance to passive stretching. Hypotonia thus manifests as diminished resistance to passive stretching. Hypotonia is not the same as muscle weakness, although the two conditions can co-exist. Evidence: TAS. Frequency: Very frequent (HP:0040281). (ORPHA:1358)
- Growth delay (HP:0001510): A deficiency or slowing down of growth pre- and postnatally. Evidence: TAS. Frequency: Frequent (HP:0040282). (ORPHA:1358)
- Abnormality of the larynx (HP:0001600): An abnormality of the larynx. Evidence: TAS. Frequency: Occasional (HP:0040283). (ORPHA:1358)
- Laryngeal stenosis (HP:0001602): Stricture or narrowing of the larynx that may be associated with symptoms of respiratory difficulty depending on the degree of laryngeal narrowing. Evidence: TAS. Frequency: Occasional (HP:0040283). (ORPHA:1358)
- Talipes equinovarus (HP:0001762): Talipes equinovarus (also called clubfoot) typically has four main components: inversion and adduction of the forefoot; inversion of the heel and hindfoot; equinus (limitation of extension) of the ankle and subtalar joint; and internal rotation of the leg. Evidence: TAS. Frequency: Frequent (HP:0040282). (ORPHA:1358)
- Ventriculomegaly (HP:0002119): An increase in size of the ventricular system of the brain. Evidence: TAS. Frequency: Occasional (HP:0040283). (ORPHA:1358)
- Cerebral calcification (HP:0002514): The presence of calcium deposition within the cerebrum. Evidence: TAS. Frequency: Occasional (HP:0040283). (ORPHA:1358)
- Scoliosis (HP:0002650): The presence of an abnormal lateral curvature of the spine. Evidence: TAS. Frequency: Frequent (HP:0040282). (ORPHA:1358)
- Short nose (HP:0003196): Distance from nasion to subnasale more than two standard deviations below the mean, or alternatively, an apparently decreased length from the nasal root to the nasal tip. Evidence: TAS. Frequency: Very frequent (HP:0040281). (ORPHA:1358)
- Myopathy (HP:0003198): A disorder of muscle unrelated to impairment of innervation or neuromuscular junction. Evidence: TAS. Frequency: Occasional (HP:0040283). (ORPHA:1358)
- Skeletal muscle atrophy (HP:0003202): The presence of skeletal muscular atrophy (which is also known as amyotrophy). Evidence: TAS. Frequency: Very frequent (HP:0040281). (ORPHA:1358)
- Short stature (HP:0004322): A height below that which is expected according to age and gender norms. Although there is no universally accepted definition of short stature, many refer to "short stature" as height more than 2 standard deviations below the mean for age and gender (or below the 3rd percentile for age and gender dependent norms). Evidence: TAS. Frequency: Frequent (HP:0040282). (ORPHA:1358)
- Cranial nerve paralysis (HP:0006824). Evidence: TAS. Frequency: Frequent (HP:0040282). (ORPHA:1358)
- Aplasia/Hypoplasia of the cerebellum (HP:0007360). Evidence: TAS. Frequency: Occasional (HP:0040283). (ORPHA:1358)
- Ulnar deviation of finger (HP:0009465): Bending or curvature of a finger toward the ulnar side (i.e., away from the thumb). The deviation is at the metacarpal-phalangeal joint, and this finding is distinct from clinodactyly. Evidence: TAS. Frequency: Occasional (HP:0040283). (ORPHA:1358)
- Aplasia of the pectoralis major muscle (HP:0009751): Absence of the pectoralis major muscle. Evidence: TAS. Frequency: Occasional (HP:0040283). (ORPHA:1358)
- Aplasia/Hypoplasia of the tongue (HP:0010295): Absence or underdevelopment of the tongue. Evidence: TAS. Frequency: Very frequent (HP:0040281). (ORPHA:1358)
- Facial palsy (HP:0010628): Facial nerve palsy is a dysfunction of cranial nerve VII (the facial nerve) that results in inability to control facial muscles on the affected side with weakness of the muscles of facial expression and eye closure. This can either be present in unilateral or bilateral form. Evidence: TAS. Frequency: Very frequent (HP:0040281). (ORPHA:1358)
- Hypertensive crisis (HP:0100735). Evidence: TAS. Frequency: Occasional (HP:0040283). (ORPHA:1358)
These phenotypes are associated with the disease Carey-Fineman-Ziter syndrome (ORPHA:1358).